- Choriocarcinoma (HP:0100768): A malignant, trophoblastic and aggressive cancer, usually of the placenta. It is characterized by early hematogenous spread to the lungs and belongs to the far end of the spectrum of gestational trophoblastic disease (GTD), a subset of germ cell tumors. Evidence: TAS. Frequency: Obligate (HP:0040280). (ORPHA:99926)
- Neoplasm (HP:0002664): An organ or organ-system abnormality that consists of uncontrolled autonomous cell-proliferation which can occur in any part of the body as a benign or malignant neoplasm (tumor). Evidence: TAS. Frequency: Very frequent (HP:0040281). (ORPHA:99926)
- Miscarriage (HP:0005268): A pregnancy that ends at a stage in which the fetus is incapable of surviving on its own, defined as the spontaneous loss of a fetus before the 22th week of pregnancy. Evidence: TAS. Frequency: Very frequent (HP:0040281). (ORPHA:99926)
- High maternal circulating chorionic gonadotropin concentration (HP:0011433): An abnormally high concentration of maternal serum human chorionic gonadotropin as compared to normal values for gestational-age. Evidence: TAS. Frequency: Very frequent (HP:0040281). (ORPHA:99926)
- Trophoblastic tumor (HP:0031502): A gestational or non-gestational neoplasm composed of neoplastic trophoblastic cells [NCIT:C3422]. Evidence: TAS. Frequency: Very frequent (HP:0040281). (ORPHA:99926)
- Metrorrhagia (HP:0100608): Bleeding at irregular intervals. Evidence: TAS. Frequency: Very frequent (HP:0040281). (ORPHA:99926)
These phenotypes are associated with the disease Gestational choriocarcinoma (ORPHA:99926).